Phenotypes associated with the disease episodic ataxia, type 9 (OMIM:618924):
- Bilateral tonic-clonic seizure (HP:0002069): A bilateral tonic-clonic seizure is a seizure defined by a tonic (bilateral increased tone, lasting seconds to minutes) and then a clonic (bilateral sustained rhythmic jerking) phase. Evidence: PCS. Frequency: 3/4. Onset: Neonatal onset (HP:0003623). (PMID:26645390)
- Bilateral tonic-clonic seizure (HP:0002069): A bilateral tonic-clonic seizure is a seizure defined by a tonic (bilateral increased tone, lasting seconds to minutes) and then a clonic (bilateral sustained rhythmic jerking) phase. Evidence: PCS. Frequency: 1/1. (PMID:27159988)
- Encephalopathy (HP:0001298): Encephalopathy is a term that means brain disease, damage, or malfunction. In general, encephalopathy is manifested by an altered mental state. Evidence: PCS. Frequency: 1/1. (PMID:27328862)
- Status epilepticus (HP:0002133): Status epilepticus is a type of prolonged seizure resulting either from the failure of the mechanisms responsible for seizure termination or from the initiation of mechanisms which lead to abnormally prolonged seizures (after time point t1). It is a condition that can have long-term consequences (after time point t2), including neuronal death, neuronal injury, and alteration of neuronal networks, depending on the type and duration of seizures. Evidence: PCS. Frequency: 1/1. (PMID:27159988)
- Vomiting (HP:0002013): Forceful ejection of the contents of the stomach through the mouth by means of a series of involuntary spasmic contractions. Evidence: PCS. Frequency: 1/1. (PMID:27328862)
- Dystonia (HP:0001332): An abnormally increased muscular tone that causes fixed abnormal postures. There is a slow, intermittent twisting motion that leads to exaggerated turning and posture of the extremities and trunk. Evidence: PCS. Frequency: 1/1. (PMID:27328862)
- Vertigo (HP:0002321): An abnormal sensation of spinning while the body is actually stationary. Evidence: PCS. Frequency: 1/1. (PMID:27159988)
- Delayed ability to stand (HP:0025335): A failure to achieve the ability to stand up at an appropriate developmental stage. Most children begin to walk alone at 11 to 15 months of age. On average, children can stand while holding on at the age of 9 to 10 months, can pull up to stand and walk with one hand being held at 12 months, and can stand alone and walk well at 18 months. Evidence: PCS. Frequency: 1/1. (PMID:27328862)
- Seizure (HP:0001250): A seizure is an intermittent abnormality of nervous system physiology characterized by a transient occurrence of signs and/or symptoms due to abnormal excessive or synchronous neuronal activity in the brain. Evidence: PCS. Frequency: 1/1. (PMID:27328862)
- Episodic ataxia (HP:0002131): Periodic spells of incoordination and imbalance, that is, episodes of ataxia typically lasting from 10 minutes to several hours or days. Evidence: PCS. Frequency: 1/1. (PMID:27159988)
- Paroxysmal vertigo (HP:0010532): Paroxysmal episodes of vertigo. Evidence: PCS. Frequency: 2/4. (PMID:26645390)
- Cerebellar edema (HP:0030915): Swelling from fluid accumulation (serous fluid infiltration into the interstitial space) in the cerebellum. Evidence: PCS. Frequency: 1/1. (PMID:27328862)
- Nystagmus (HP:0000639): Rhythmic, involuntary oscillations of one or both eyes related to abnormality in fixation, conjugate gaze, or vestibular mechanisms. Evidence: PCS. Frequency: 1/1. (PMID:27328862)
- Tonic seizure (HP:0032792): A tonic seizure is a type of motor seizure characterized by unilateral or bilateral limb stiffening or elevation, often with neck stiffening. Evidence: PCS. Frequency: 1/4. Onset: Neonatal onset (HP:0003623). (PMID:26645390)
- Tonic seizure (HP:0032792): A tonic seizure is a type of motor seizure characterized by unilateral or bilateral limb stiffening or elevation, often with neck stiffening. Evidence: PCS. Frequency: 1/1. (PMID:27159988)
- Arachnoid cyst (HP:0100702): An extra-parenchymal and intra-arachnoidal collection of fluid with a composition similar to that of cerebrospinal fluid. Evidence: PCS. Frequency: 1/1. (PMID:27328862)
- Clonic seizure (HP:0020221): A clonic seizure is a type of motor seizure characterized by sustained rhythmic jerking, that is regularly repetitive. Evidence: PCS. Frequency: 1/4. Onset: Neonatal onset (HP:0003623). (PMID:26645390)
- Autosomal dominant inheritance (HP:0000006): A mode of inheritance that is observed for traits related to a gene encoded on one of the autosomes (i.e., the human chromosomes 1-22) in which a trait manifests in heterozygotes. In the context of medical genetics, an autosomal dominant disorder is caused when a single copy of the mutant allele is present. Males and females are affected equally, and can both transmit the disorder with a risk of 50% for each child of inheriting the mutant allele. Evidence: PCS. (PMID:26645390)